- Abnormal oral cavity morphology (HP:0000163): Abnormality of the oral cavity, i.e., the opening or hollow part of the mouth. Evidence: TAS. Frequency: Frequent (HP:0040282). (ORPHA:101023)
- Language impairment (HP:0002463): Language impairment is a deficit in comprehension or production of language that includes reduced vocabulary, limited sentence structure, or impairments in written or spoken communication. Language abilities are substantially and quantifiably below age expectations. Evidence: TAS. Frequency: Frequent (HP:0040282). (ORPHA:101023)
- Obstructive sleep apnea (HP:0002870): Obstructive Sleep Apnea is a condition characterized by the obstruction of the airway and pauses in breathing during sleep, which occur multiple times throughout the night. It is related to the relaxation of muscle tone that typically happens during sleep, leading to a partial collapse of the soft tissues in the airway and causing airflow obstruction. Evidence: TAS. Frequency: Frequent (HP:0040282). (ORPHA:101023)
- Feeding difficulties in infancy (HP:0008872): Impaired feeding performance of an infant as manifested by difficulties such as weak and ineffective sucking, brief bursts of sucking, and falling asleep during sucking. There may be difficulties with chewing or maintaining attention. Evidence: TAS. Frequency: Frequent (HP:0040282). (ORPHA:101023)
- Conductive hearing impairment (HP:0000405): An abnormality of vibrational conductance of sound to the inner ear leading to impairment of sensory perception of sound. Evidence: TAS. Frequency: Occasional (HP:0040283). (ORPHA:101023)
These phenotypes are associated with the disease Cleft hard palate (ORPHA:101023).